Phenotypes associated with the disease Palmoplantar keratoderma-spastic paralysis syndrome (ORPHA:2201):
- Palmoplantar keratoderma (HP:0000982): Abnormal thickening of the skin of the palms of the hands and the soles of the feet. Evidence: TAS. Frequency: Very frequent (HP:0040281). (ORPHA:2201)
- Thickened skin (HP:0001072): Laminar thickening of skin. Evidence: TAS. Frequency: Very frequent (HP:0040281). (ORPHA:2201)
- Abnormal fingernail morphology (HP:0001231): An abnormality of the fingernails. Evidence: TAS. Frequency: Very frequent (HP:0040281). (ORPHA:2201)
- Gait disturbance (HP:0001288): The term gait disturbance can refer to any disruption of the ability to walk. Evidence: TAS. Frequency: Very frequent (HP:0040281). (ORPHA:2201)
- Pes cavus (HP:0001761): An increase in height of the medial longitudinal arch of the foot that does not flatten on weight bearing (i.e., a distinctly hollow form of the sole of the foot when it is bearing weight). Evidence: TAS. Frequency: Very frequent (HP:0040281). (ORPHA:2201)
- EMG abnormality (HP:0003457): Abnormal results of investigations using electromyography (EMG). Evidence: TAS. Frequency: Very frequent (HP:0040281). (ORPHA:2201)
- Pain insensitivity (HP:0007021): Inability to perceive painful stimuli. Evidence: TAS. Frequency: Very frequent (HP:0040281). (ORPHA:2201)
- Abnormal toenail morphology (HP:0008388): An anomaly of the toenail. Evidence: TAS. Frequency: Very frequent (HP:0040281). (ORPHA:2201)
- Peripheral neuropathy (HP:0009830): Peripheral neuropathy is a general term for any disorder of the peripheral nervous system. The main clinical features used to classify peripheral neuropathy are distribution, type (mainly demyelinating versus mainly axonal), duration, and course. Evidence: TAS. Frequency: Very frequent (HP:0040281). (ORPHA:2201)
- Muscle flaccidity (HP:0010547): A type of paralysis in which a muscle becomes soft and yields to passive stretching, which results from loss of all or practically all peripheral motor nerves that innervated the muscle. Muscle tone is reduced and the affected muscles undergo extreme atrophy within months of the loss of innervation. Evidence: TAS. Frequency: Very frequent (HP:0040281). (ORPHA:2201)
- Spasticity (HP:0001257): A motor disorder characterized by a velocity-dependent increase in tonic stretch reflexes with increased muscle tone, exaggerated (hyperexcitable) tendon reflexes. Evidence: TAS. Frequency: Frequent (HP:0040282). (ORPHA:2201)
- Hemiplegia (HP:0002301): Paralysis (complete loss of muscle function) in the arm, leg, and in some cases the face on one side of the body. Evidence: TAS. Frequency: Frequent (HP:0040282). (ORPHA:2201)